- Abnormality of the dentition (HP:0000164): Any abnormality of the teeth. Evidence: IEA. (OMIM:251700)
- High hypermetropia (HP:0008499): A severe form of hypermetropia with over +5.00 diopters. Evidence: IEA. (OMIM:251700)
- Autosomal recessive inheritance (HP:0000007): A mode of inheritance that is observed for traits related to a gene encoded on one of the autosomes (i.e., the human chromosomes 1-22) in which a trait manifests in individuals with two pathogenic alleles, either homozygotes (two copies of the same mutant allele) or compound heterozygotes (whereby each copy of a gene has a distinct mutant allele). Evidence: IEA. (OMIM:251700)
- Retinal degeneration (HP:0000546): A nonspecific term denoting progressive loss of the retinal pigment epithelium (RPE) and/or neurosensory retinal cells. Evidence: IEA. (OMIM:251700)
- Microphthalmia (HP:0000568): A developmental anomaly characterized by abnormal smallness of one or both eyes. Evidence: IEA. (OMIM:251700)
- Glaucoma (HP:0000501): Glaucoma refers loss of retinal ganglion cells in a characteristic pattern of optic neuropathy usually associated with increased intraocular pressure. Evidence: IEA. (OMIM:251700)
These phenotypes are associated with the disease microphthalmia with hyperopia, retinal degeneration, macrophakia, and dental anomalies (OMIM:251700).